- Male infertility (HP:0003251). Evidence: TAS. Frequency: 4/4. (PMID:30893644)
- Young adult onset (HP:0011462): Onset of disease at the age of between 16 and 40 years. Evidence: PCS. Frequency: 4/4. (PMID:30893644)
- Autosomal dominant inheritance (HP:0000006): A mode of inheritance that is observed for traits related to a gene encoded on one of the autosomes (i.e., the human chromosomes 1-22) in which a trait manifests in heterozygotes. In the context of medical genetics, an autosomal dominant disorder is caused when a single copy of the mutant allele is present. Males and females are affected equally, and can both transmit the disorder with a risk of 50% for each child of inheriting the mutant allele. Evidence: PCS. (PMID:30893644)
- Abnormal sperm morphology (HP:0012864): A structural anomaly of sperm. Evidence: TAS. Frequency: 3/3. (PMID:30893644)
These phenotypes are associated with the disease spermatogenic failure 36 (OMIM:618420).